Phenotypes associated with the disease Danon disease (ORPHA:34587):
- Intellectual disability (HP:0001249): The term intellectual disability or intellectual developmental disorder is used to describe significantly sub-average intellectual and adaptive functioning based on clinical assessment and as measured by individually administered, appropriately normed, standardized and validated tests of intellectual functioning and adaptive behavior, with onset during the developmental period from infancy through adolescence. Evidence: TAS. Frequency: Very frequent (HP:0040281). (ORPHA:34587)
- Gait disturbance (HP:0001288): The term gait disturbance can refer to any disruption of the ability to walk. Evidence: TAS. Frequency: Very frequent (HP:0040281). (ORPHA:34587)
- Hypertrophic cardiomyopathy (HP:0001639): Hypertrophic cardiomyopathy (HCM) is defined by the presence of increased ventricular wall thickness or mass in the absence of loading conditions (hypertension, valve disease) sufficient to cause the observed abnormality. Evidence: TAS. Frequency: Very frequent (HP:0040281). (ORPHA:34587)
- Dilated cardiomyopathy (HP:0001644): Dilated cardiomyopathy (DCM) is defined by the presence of left ventricular dilatation and left ventricular systolic dysfunction in the absence of abnormal loading conditions (hypertension, valve disease) or coronary artery disease sufficient to cause global systolic impairment. Right ventricular dilation and dysfunction may be present but are not necessary for the diagnosis. Evidence: TAS. Frequency: Very frequent (HP:0040281). (ORPHA:34587)
- Cardiorespiratory arrest (HP:0006543). Evidence: TAS. Frequency: Very frequent (HP:0040281). (ORPHA:34587)
- Muscle flaccidity (HP:0010547): A type of paralysis in which a muscle becomes soft and yields to passive stretching, which results from loss of all or practically all peripheral motor nerves that innervated the muscle. Muscle tone is reduced and the affected muscles undergo extreme atrophy within months of the loss of innervation. Evidence: TAS. Frequency: Very frequent (HP:0040281). (ORPHA:34587)